- Typified by somatic mosaicism (HP:0001442): Description of conditions in which affected individuals typically display somatic mosaicism, i.e., genetically distinct populations of somatic cells in a given organism caused by DNA mutations, epigenetic alterations of DNA, chromosomal abnormalities or the spontaneous reversion of inherited mutations. In many conditions typified by somatic mosaicism, constitutive mutation is lethal and cases are exclusively or predominantly mosaic. Evidence: TAS. (OMIM:614286)
- Myelodysplasia (HP:0002863): Clonal hematopoietic stem cell disorders characterized by dysplasia (ineffective production) in one or more hematopoietic cell lineages, leading to anemia and cytopenia. Evidence: TAS. (OMIM:614286)
These phenotypes are associated with the disease myelodysplastic syndrome (OMIM:614286).